Phenotypes associated with the disease intellectual disability, X-linked 82 (OMIM:300518):
- EEG abnormality (HP:0002353): Abnormality observed by electroencephalogram (EEG), which is used to record of the brain's spontaneous electrical activity from multiple electrodes placed on the scalp. Evidence: TAS. (OMIM:300518)
- Scoliosis (HP:0002650): The presence of an abnormal lateral curvature of the spine. Evidence: TAS. (OMIM:300518)
- Seizure (HP:0001250): A seizure is an intermittent abnormality of nervous system physiology characterized by a transient occurrence of signs and/or symptoms due to abnormal excessive or synchronous neuronal activity in the brain. Evidence: TAS. (OMIM:300518)
- X-linked recessive inheritance (HP:0001419): A mode of inheritance that is observed for recessive traits related to a gene encoded on the X chromosome. In the context of medical genetics, X-linked recessive disorders manifest in males (who have one copy of the X chromosome and are thus hemizygotes), but generally not in female heterozygotes who have one mutant and one normal allele. Evidence: TAS. (OMIM:300518)
- Kyphosis (HP:0002808): Exaggerated anterior convexity of the thoracic vertebral column. Evidence: TAS. (OMIM:300518)
- Autistic behavior (HP:0000729): Persistent deficits in social interaction and communication and interaction as well as a markedly restricted repertoire of activity and interest as well as repetitive patterns of behavior. Evidence: TAS. (OMIM:300518)
- Intellectual disability (HP:0001249): The term intellectual disability or intellectual developmental disorder is used to describe significantly sub-average intellectual and adaptive functioning based on clinical assessment and as measured by individually administered, appropriately normed, standardized and validated tests of intellectual functioning and adaptive behavior, with onset during the developmental period from infancy through adolescence. Evidence: TAS. (OMIM:300518)